Phenotypes associated with the disease autosomal recessive nonsyndromic hearing loss 44 (OMIM:610154):
- Autosomal recessive inheritance (HP:0000007): A mode of inheritance that is observed for traits related to a gene encoded on one of the autosomes (i.e., the human chromosomes 1-22) in which a trait manifests in individuals with two pathogenic alleles, either homozygotes (two copies of the same mutant allele) or compound heterozygotes (whereby each copy of a gene has a distinct mutant allele). Evidence: IEA. (OMIM:610154)
- Prelingual sensorineural hearing impairment (HP:0000399): A form of sensorineural deafness with either congenital onset or infantile onset, i.e., before the acquisition of speech. Evidence: IEA. (OMIM:610154)